Phenotypes associated with the disease Haddad syndrome (ORPHA:99803):
- Strabismus (HP:0000486): A misalignment of the eyes so that the visual axes deviate from bifoveal fixation. The classification of strabismus may be based on a number of features including the relative position of the eyes, whether the deviation is latent or manifest, intermittent or constant, concomitant or otherwise and according to the age of onset and the relevance of any associated refractive error. Evidence: TAS. Frequency: Very frequent (HP:0040281). (ORPHA:99803)
- Failure to thrive (HP:0001508): Failure to thrive (FTT) refers to a child whose physical growth is substantially below the norm. Evidence: TAS. Frequency: Very frequent (HP:0040281). (ORPHA:99803)
- Small for gestational age (HP:0001518): Smaller than normal size according to sex and gestational age related norms, defined as a weight below the 10th percentile for the gestational age. Evidence: TAS. Frequency: Very frequent (HP:0040281). (ORPHA:99803)
- Aganglionic megacolon (HP:0002251): An abnormality resulting from a lack of intestinal ganglion cells (i.e., an aganglionic section of bowel) that results in bowel obstruction with enlargement of the colon. Evidence: TAS. Frequency: Very frequent (HP:0040281). (ORPHA:99803)
- Breathing dysregulation (HP:0005957). Evidence: TAS. Frequency: Very frequent (HP:0040281). (ORPHA:99803)
- Central hypoventilation (HP:0007110). Evidence: TAS. Frequency: Very frequent (HP:0040281). (ORPHA:99803)
- Central sleep apnea (HP:0010536): Sleep apnea results from a temporary loss of the central drive to the muscles responsible for breathing. Evidence: TAS. Frequency: Very frequent (HP:0040281). (ORPHA:99803)
- Abnormal autonomic nervous system physiology (HP:0012332): A functional abnormality of the autonomic nervous system. Evidence: TAS. Frequency: Very frequent (HP:0040281). (ORPHA:99803)
- Intellectual disability (HP:0001249): The term intellectual disability or intellectual developmental disorder is used to describe significantly sub-average intellectual and adaptive functioning based on clinical assessment and as measured by individually administered, appropriately normed, standardized and validated tests of intellectual functioning and adaptive behavior, with onset during the developmental period from infancy through adolescence. Evidence: TAS. Frequency: Frequent (HP:0040282). (ORPHA:99803)
- Seizure (HP:0001250): A seizure is an intermittent abnormality of nervous system physiology characterized by a transient occurrence of signs and/or symptoms due to abnormal excessive or synchronous neuronal activity in the brain. Evidence: TAS. Frequency: Frequent (HP:0040282). (ORPHA:99803)
- Hypotonia (HP:0001252): Hypotonia is an abnormally low muscle tone (the amount of tension or resistance to movement in a muscle). Even when relaxed, muscles have a continuous and passive partial contraction which provides some resistance to passive stretching. Hypotonia thus manifests as diminished resistance to passive stretching. Hypotonia is not the same as muscle weakness, although the two conditions can co-exist. Evidence: TAS. Frequency: Frequent (HP:0040282). (ORPHA:99803)
- Death in infancy (HP:0001522): Death within the first 24 months of life. Evidence: TAS. Frequency: Frequent (HP:0040282). (ORPHA:99803)
- Gastroesophageal reflux (HP:0002020): A condition in which the stomach contents leak backwards from the stomach into the esophagus through the lower esophageal sphincter. Evidence: TAS. Frequency: Frequent (HP:0040282). (ORPHA:99803)
- Sensorineural hearing impairment (HP:0000407): A type of hearing impairment in one or both ears related to an abnormal functionality of the cochlear nerve. Evidence: TAS. Frequency: Occasional (HP:0040283). (ORPHA:99803)
- Decreased fetal movement (HP:0001558): An abnormal reduction in quantity or strength of fetal movements. Evidence: TAS. Frequency: Occasional (HP:0040283). (ORPHA:99803)
- Polyhydramnios (HP:0001561): The presence of excess amniotic fluid in the uterus during pregnancy. Evidence: TAS. Frequency: Occasional (HP:0040283). (ORPHA:99803)
- Oligohydramnios (HP:0001562): Diminished amniotic fluid volume in pregnancy. Evidence: TAS. Frequency: Occasional (HP:0040283). (ORPHA:99803)
- Ganglioneuroma (HP:0003005): A benign neoplasm that usually arises from the sympathetic trunk in the mediastinum, representing a tumor of the sympathetic nerve fibers arising from neural crest cells. Evidence: TAS. Frequency: Occasional (HP:0040283). (ORPHA:99803)
- Neuroblastoma (HP:0003006): Neuroblastoma is a solid tumor that originate in neural crest cells of the sympathetic nervous system. Most neuroblastomas originate in the abdomen, and most abdominal neuroblastomas originate in the adrenal gland. Neuroblastomas can also originate in the thorax, usually in the posterior mediastinum. Evidence: TAS. Frequency: Occasional (HP:0040283). (ORPHA:99803)